Phenotypes associated with the disease immunodeficiency 74, COVID-19-related, X-linked (OMIM:301051):
- Severe SARS-CoV-2 infection (HP:0033141): Unusually severe clinical course of SARS-CoV-2 infection, manifested clinically by features such as dyspnea and hypoxia with diffuse bilateral ground-glass opacities of the lungs on computed tomographic scan with progressive respiratory insufficiency necessitating oxygen supplementation or mechanical ventilation. Evidence: PCS. Frequency: 4/4. (PMID:32706371)
- X-linked recessive inheritance (HP:0001419): A mode of inheritance that is observed for recessive traits related to a gene encoded on the X chromosome. In the context of medical genetics, X-linked recessive disorders manifest in males (who have one copy of the X chromosome and are thus hemizygotes), but generally not in female heterozygotes who have one mutant and one normal allele. Evidence: PCS. (PMID:32706371)
- Severe viral infection (HP:0031691): An unusually severe viral infection. Evidence: PCS. Frequency: 4/4. (PMID:32706371)